Phenotypes associated with the disease Temple syndrome due to maternal uniparental disomy of chromosome 14 (ORPHA:96184):
- Precocious puberty (HP:0000826): The onset of secondary sexual characteristics before a normal age. Although it is difficult to define normal age ranges because of the marked variation with which puberty begins in normal children, precocious puberty can be defined as the onset of puberty before the age of 8 years in girls or 9 years in boys. Evidence: TAS. Frequency: Very frequent (HP:0040281). (ORPHA:96184)
- Hypotonia (HP:0001252): Hypotonia is an abnormally low muscle tone (the amount of tension or resistance to movement in a muscle). Even when relaxed, muscles have a continuous and passive partial contraction which provides some resistance to passive stretching. Hypotonia thus manifests as diminished resistance to passive stretching. Hypotonia is not the same as muscle weakness, although the two conditions can co-exist. Evidence: TAS. Frequency: Very frequent (HP:0040281). (ORPHA:96184)
- Motor delay (HP:0001270): A type of Developmental delay characterized by a delay in acquiring motor skills. Evidence: TAS. Frequency: Very frequent (HP:0040281). (ORPHA:96184)
- Short foot (HP:0001773): A measured foot length that is more than 2 SD below the mean for a newborn of 27 - 41 weeks gestation, or foot that is less than the 3rd centile for individuals from birth to 16 years of age (objective). Alternatively, a foot that appears disproportionately short (subjective). Evidence: TAS. Frequency: Very frequent (HP:0040281). (ORPHA:96184)
- Postnatal growth retardation (HP:0008897): Slow or limited growth after birth. Evidence: TAS. Frequency: Very frequent (HP:0040281). (ORPHA:96184)
- Small hand (HP:0200055): Disproportionately small hand. Evidence: TAS. Frequency: Very frequent (HP:0040281). (ORPHA:96184)
- Delayed speech and language development (HP:0000750): A degree of language development that is significantly below the norm for a child of a specified age. Evidence: TAS. Frequency: Frequent (HP:0040282). (ORPHA:96184)
- Intellectual disability (HP:0001249): The term intellectual disability or intellectual developmental disorder is used to describe significantly sub-average intellectual and adaptive functioning based on clinical assessment and as measured by individually administered, appropriately normed, standardized and validated tests of intellectual functioning and adaptive behavior, with onset during the developmental period from infancy through adolescence. Evidence: TAS. Frequency: Frequent (HP:0040282). (ORPHA:96184)
- Joint hypermobility (HP:0001382): The capability that a joint (or a group of joints) has to move, passively and/or actively, beyond normal limits along physiological axes. Evidence: TAS. Frequency: Frequent (HP:0040282). (ORPHA:96184)
- Intrauterine growth retardation (HP:0001511): An abnormal restriction of fetal growth with fetal weight below the tenth percentile for gestational age. Evidence: TAS. Frequency: Frequent (HP:0040282). (ORPHA:96184)
- Obesity (HP:0001513): Accumulation of substantial excess body fat. Evidence: TAS. Frequency: Frequent (HP:0040282). (ORPHA:96184)
- Small for gestational age (HP:0001518): Smaller than normal size according to sex and gestational age related norms, defined as a weight below the 10th percentile for the gestational age. Evidence: TAS. Frequency: Frequent (HP:0040282). (ORPHA:96184)
- Premature birth (HP:0001622): The birth of a baby of less than 37 weeks of gestational age. Evidence: TAS. Frequency: Frequent (HP:0040282). (ORPHA:96184)
- Truncal obesity (HP:0001956): Obesity located preferentially in the trunk of the body as opposed to the extremities. Evidence: TAS. Frequency: Frequent (HP:0040282). (ORPHA:96184)
- Short stature (HP:0004322): A height below that which is expected according to age and gender norms. Although there is no universally accepted definition of short stature, many refer to "short stature" as height more than 2 standard deviations below the mean for age and gender (or below the 3rd percentile for age and gender dependent norms). Evidence: TAS. Frequency: Frequent (HP:0040282). (ORPHA:96184)
- Cryptorchidism (HP:0000028): Testis in inguinal canal. That is, absence of one or both testes from the scrotum owing to failure of the testis or testes to descend through the inguinal canal to the scrotum. Evidence: TAS. Frequency: Occasional (HP:0040283). (ORPHA:96184)
- Narrow mouth (HP:0000160): Distance between the commissures of the mouth more than 2 SD below the mean. Alternatively, an apparently decreased width of the oral aperture (subjective). Evidence: TAS. Frequency: Occasional (HP:0040283). (ORPHA:96184)
- Cleft palate (HP:0000175): Cleft palate is a developmental defect of the palate resulting from a failure of fusion of the palatine processes and manifesting as a separation of the roof of the mouth (soft and hard palate). Evidence: TAS. Frequency: Occasional (HP:0040283). (ORPHA:96184)
- Bifid uvula (HP:0000193): Uvula separated into two parts most easily seen at the tip. Evidence: TAS. Frequency: Occasional (HP:0040283). (ORPHA:96184)
- High palate (HP:0000218): Height of the palate more than 2 SD above the mean (objective) or palatal height at the level of the first permanent molar more than twice the height of the teeth (subjective). Evidence: TAS. Frequency: Occasional (HP:0040283). (ORPHA:96184)
- Full cheeks (HP:0000293): Increased prominence or roundness of soft tissues between zygomata and mandible. Evidence: TAS. Frequency: Occasional (HP:0040283). (ORPHA:96184)
- Short philtrum (HP:0000322): Distance between nasal base and midline upper lip vermilion border more than 2 SD below the mean. Alternatively, an apparently decreased distance between nasal base and midline upper lip vermilion border. Evidence: TAS. Frequency: Occasional (HP:0040283). (ORPHA:96184)
- Micrognathia (HP:0000347): Developmental hypoplasia of the mandible. Evidence: TAS. Frequency: Occasional (HP:0040283). (ORPHA:96184)
- Recurrent otitis media (HP:0000403): Increased susceptibility to otitis media, as manifested by recurrent episodes of otitis media. Evidence: TAS. Frequency: Occasional (HP:0040283). (ORPHA:96184)
- Wide nose (HP:0000445): Interalar distance more than two standard deviations above the mean for age, i.e., an apparently increased width of the nasal base and alae. Evidence: TAS. Frequency: Occasional (HP:0040283). (ORPHA:96184)
- Anteverted nares (HP:0000463): Anteriorly-facing nostrils viewed with the head in the Frankfurt horizontal and the eyes of the observer level with the eyes of the subject. This gives the appearance of an upturned nose (upturned nasal tip). Evidence: TAS. Frequency: Occasional (HP:0040283). (ORPHA:96184)
- Pyloric stenosis (HP:0002021): Pyloric stenosis, also known as infantile hypertrophic pyloric stenosis, is an uncommon condition in infants characterized by abnormal thickening of the pylorus muscles in the stomach leading to gastric outlet obstruction. Clinically infants are well at birth. Then, at 3 to 6 weeks of age, the infants present with projectile vomiting, potentially leading to dehydration and weight loss. Evidence: TAS. Frequency: Occasional (HP:0040283). (ORPHA:96184)
- Scoliosis (HP:0002650): The presence of an abnormal lateral curvature of the spine. Evidence: TAS. Frequency: Occasional (HP:0040283). (ORPHA:96184)
- Hypercholesterolemia (HP:0003124): An increased concentration of cholesterol in the blood. Evidence: TAS. Frequency: Occasional (HP:0040283). (ORPHA:96184)
- Maturity-onset diabetes of the young (HP:0004904): The term Maturity-onset diabetes of the young (MODY) was initially used for patients diagnosed with fasting hyperglycemia that could be treated without insulin for more than two years, where the initial diagnosis was made at a young age (under 25 years). Thus, MODY combines characteristics of type 1 diabetes (young age at diagnosis) and type 2 diabetes (less insulin dependence than type 1 diabetes). The term MODY is now most often used to refer to a group of monogenic diseases with these characteristics. Here, the term is used to describe hyperglycemia diagnosed at a young age with no or minor insulin dependency, no evidence of insulin resistance, and lack of evidence of autoimmune destruction of the beta cells. Evidence: TAS. Frequency: Occasional (HP:0040283). (ORPHA:96184)
- Depressed nasal bridge (HP:0005280): Posterior positioning of the nasal root in relation to the overall facial profile for age. Evidence: TAS. Frequency: Occasional (HP:0040283). (ORPHA:96184)
- Poor fine motor coordination (HP:0007010): An abnormality of the ability (skills) to perform a precise movement of small muscles with the intent to perform a specific act. Fine motor skills are required to mediate movements of the wrists, hands, fingers, feet, and toes. Evidence: TAS. Frequency: Occasional (HP:0040283). (ORPHA:96184)
- Prominent forehead (HP:0011220): Forward prominence of the entire forehead, due to protrusion of the frontal bone. Evidence: TAS. Frequency: Occasional (HP:0040283). (ORPHA:96184)
- Feeding difficulties (HP:0011968): Impaired ability to eat related to problems gathering food and getting ready to suck, chew, or swallow it. Evidence: TAS. Frequency: Occasional (HP:0040283). (ORPHA:96184)
- Clinodactyly (HP:0030084): An angulation of a digit at an interphalangeal joint in the plane of the palm (finger) or sole (toe). Evidence: TAS. Frequency: Occasional (HP:0040283). (ORPHA:96184)